- Goiter (HP:0000853): An enlargement of the thyroid gland. Evidence: TAS. Frequency: Obligate (HP:0040280). (ORPHA:97285)
- Lymphoma (HP:0002665): A cancer originating in lymphocytes and presenting as a solid tumor of lymhpoid cells. Evidence: TAS. Frequency: Obligate (HP:0040280). (ORPHA:97285)
- Broad neck (HP:0000475): Increased side-to-side width of the neck. Evidence: TAS. Frequency: Very frequent (HP:0040281). (ORPHA:97285)
- Hypothyroidism (HP:0000821): Deficiency of thyroid hormone. Evidence: TAS. Frequency: Frequent (HP:0040282). (ORPHA:97285)
- Hashimoto thyroiditis (HP:0000872): A chronic, autoimmune type of thyroiditis associated with hypothyroidism. Evidence: TAS. Frequency: Frequent (HP:0040282). (ORPHA:97285)
- Hoarse voice (HP:0001609): Hoarseness refers to a change in the pitch or quality of the voice, with the voice sounding weak, very breathy, scratchy, or husky. Evidence: TAS. Frequency: Frequent (HP:0040282). (ORPHA:97285)
- Dysphagia (HP:0002015): Difficulty in swallowing. Evidence: TAS. Frequency: Frequent (HP:0040282). (ORPHA:97285)
- Dyspnea (HP:0002094): Difficult or labored breathing. Dyspnea is a subjective feeling only the patient can rate, e.g., on a Borg scale. Evidence: TAS. Frequency: Frequent (HP:0040282). (ORPHA:97285)
- Lymphadenopathy (HP:0002716): Enlargement (swelling) of a lymph node. Evidence: TAS. Frequency: Frequent (HP:0040282). (ORPHA:97285)
- Upper airway obstruction (HP:0002781): Increased resistance to the passage of air in the upper airway. Evidence: TAS. Frequency: Frequent (HP:0040282). (ORPHA:97285)
- Stridor (HP:0010307): Stridor is a high pitched sound resulting from turbulent air flow in the upper airway. Evidence: TAS. Frequency: Frequent (HP:0040282). (ORPHA:97285)
- Hyperthyroidism (HP:0000836): An abnormality of thyroid physiology characterized by excessive secretion of the thyroid hormones thyroxine (i.e., T4) and/or 3,3',5-triiodo-L-thyronine zwitterion (i.e., triiodothyronine or T3). Evidence: TAS. Frequency: Occasional (HP:0040283). (ORPHA:97285)
- Pain (HP:0012531): An unpleasant sensory and emotional experience associated with actual or potential tissue damage, or described in terms of such damage. Evidence: TAS. Frequency: Occasional (HP:0040283). (ORPHA:97285)
- Respiratory distress (HP:0002098): Respiratory distress is objectively observable as the physical or emotional consequences from the experience of dyspnea. The physical presentation of respiratory distress is generally referred to as labored breathing, while the sensation of respiratory distress is called shortness of breath or dyspnea. Evidence: TAS. Frequency: Very rare (HP:0040284). (ORPHA:97285)
These phenotypes are associated with the disease Thyroid lymphoma (ORPHA:97285).